Phenotypes associated with the disease Mounier-Kuhn syndrome (OMIM:275300):
- Recurrent bronchopulmonary infections (HP:0006538): An increased susceptibility to bronchopulmonary infections as manifested by a history of recurrent bronchopulmonary infections. Evidence: IEA. (OMIM:275300)
- Bronchiectasis (HP:0002110): Persistent abnormal dilatation of the bronchi owing to localized and irreversible destruction and widening of the large airways. Evidence: IEA. (OMIM:275300)
- Diverticulosis of trachea (HP:0006509): Tracheal diverticula are blind-ended outpouchings arising from the trachea. They are usually an incidental finding. Occasionally they can mimic pneumomediastinum. Tracheal diverticula are either congenital or acquired, in the latter case the most common causes are prolonged increased intraluminal pressure, e.g. chronic cough, COPD, tracheomalacia, and iatrogenic (e.g. post-surgical). Evidence: IEA. (OMIM:275300)
- Autosomal recessive inheritance (HP:0000007): A mode of inheritance that is observed for traits related to a gene encoded on one of the autosomes (i.e., the human chromosomes 1-22) in which a trait manifests in individuals with two pathogenic alleles, either homozygotes (two copies of the same mutant allele) or compound heterozygotes (whereby each copy of a gene has a distinct mutant allele). Evidence: IEA. (OMIM:275300)
- Death in infancy (HP:0001522): Death within the first 24 months of life. Evidence: IEA. (OMIM:275300)